- Incoordination (HP:0002311): A deficit in coordination of muscle movements. Coordination is defined as the orchestrated movement of multiple body parts as required to accomplish intended actions, like walking. Evidence: IEA. (OMIM:126200)
- Paresthesia (HP:0003401): Abnormal sensations such as tingling, pricking, or numbness of the skin with no apparent physical cause. Evidence: IEA. (OMIM:126200)
- Diplopia (HP:0000651): Diplopia is a condition in which a single object is perceived as two images, it is also known as double vision. Evidence: IEA. (OMIM:126200)
- Depression (HP:0000716): Frequently experiencing feelings of being down, miserable, and/or hopeless; struggling to recover from these moods; having a pessimistic outlook on the future; feeling a pervasive sense of shame; having a low self-worth; experiencing thoughts of suicide and engaging in suicidal behavior. Evidence: IEA. (OMIM:126200)
- Urinary incontinence (HP:0000020): Loss of the ability to control the urinary bladder leading to involuntary urination. Evidence: IEA. (OMIM:126200)
- Adult onset (HP:0003581): Onset of disease manifestations in adulthood, defined here as at the age of 16 years or later. Evidence: TAS. (OMIM:126200)
- Urinary hesitancy (HP:0000019): Difficulty in beginning the process of urination. Evidence: IEA. (OMIM:126200)
- Emotional lability (HP:0000712): Unstable emotional experiences and frequent mood changes; emotions that are easily aroused, intense, and/or disproportionate to events and circumstances. Evidence: IEA. (OMIM:126200)
- Non-Mendelian inheritance (HP:0001426): A mode of inheritance that depends on genetic determinants in more than one gene. Evidence: IEA. (OMIM:126200)
- Muscle weakness (HP:0001324): Reduced strength of muscles. Evidence: TAS. (OMIM:126200)
- Spasticity (HP:0001257): A motor disorder characterized by a velocity-dependent increase in tonic stretch reflexes with increased muscle tone, exaggerated (hyperexcitable) tendon reflexes. Evidence: IEA. (OMIM:126200)
- CNS demyelination (HP:0007305): A loss of myelin from nerve fibers in the central nervous system. Evidence: TAS. (OMIM:126200)
These phenotypes are associated with the disease multiple sclerosis, susceptibility to 1 (OMIM:126200).